Phenotypes associated with the disease Usher syndrome type 1K (OMIM:614990):
- Congenital onset (HP:0003577): A phenotypic abnormality that is present at birth. Evidence: TAS. (OMIM:614990)
- Abnormal vestibular function (HP:0001751): An abnormality of the functioning of the vestibular apparatus. Evidence: TAS. (OMIM:614990)
- Autosomal recessive inheritance (HP:0000007): A mode of inheritance that is observed for traits related to a gene encoded on one of the autosomes (i.e., the human chromosomes 1-22) in which a trait manifests in individuals with two pathogenic alleles, either homozygotes (two copies of the same mutant allele) or compound heterozygotes (whereby each copy of a gene has a distinct mutant allele). Evidence: TAS. (OMIM:614990)
- Motor delay (HP:0001270): A type of Developmental delay characterized by a delay in acquiring motor skills. Evidence: TAS. (OMIM:614990)
- Rod-cone dystrophy (HP:0000510): An inherited retinal disease subtype in which the rod photoreceptors appear to be more severely affected than the cone photoreceptors. Typical presentation is with nyctalopia (due to rod dysfunction) followed by loss of mid-peripheral field of vision, which gradually extends and leaves many patients with a small central island of vision due to the preservation of macular cones. Evidence: TAS. (OMIM:614990)